Phenotypes associated with the disease multiple congenital anomalies-hypotonia-seizures syndrome 3 (OMIM:615398):
- Nephrocalcinosis (HP:0000121): Nephrocalcinosis is the deposition of calcium salts in renal parenchyma. Evidence: TAS. (OMIM:615398)
- Bilateral tonic-clonic seizure (HP:0002069): A bilateral tonic-clonic seizure is a seizure defined by a tonic (bilateral increased tone, lasting seconds to minutes) and then a clonic (bilateral sustained rhythmic jerking) phase. Evidence: PCS. Frequency: 1/4. (PMID:23636107)
- Abnormality of the dentition (HP:0000164): Any abnormality of the teeth. Evidence: TAS. (OMIM:615398)
- Strabismus (HP:0000486): A misalignment of the eyes so that the visual axes deviate from bifoveal fixation. The classification of strabismus may be based on a number of features including the relative position of the eyes, whether the deviation is latent or manifest, intermittent or constant, concomitant or otherwise and according to the age of onset and the relevance of any associated refractive error. Evidence: PCS. Frequency: 4/4. (PMID:23636107)
- Lambdoidal craniosynostosis (HP:0004443): A kind of craniosynostosis affecting the lambdoidal suture. Evidence: PCS. Frequency: 1/2. (PMID:23636107)
- Seizure (HP:0001250): A seizure is an intermittent abnormality of nervous system physiology characterized by a transient occurrence of signs and/or symptoms due to abnormal excessive or synchronous neuronal activity in the brain. Evidence: TAS. (OMIM:615398)
- Hypotonia (HP:0001252): Hypotonia is an abnormally low muscle tone (the amount of tension or resistance to movement in a muscle). Even when relaxed, muscles have a continuous and passive partial contraction which provides some resistance to passive stretching. Hypotonia thus manifests as diminished resistance to passive stretching. Hypotonia is not the same as muscle weakness, although the two conditions can co-exist. Evidence: PCS. Frequency: 4/4. (PMID:23636107)
- Short nose (HP:0003196): Distance from nasion to subnasale more than two standard deviations below the mean, or alternatively, an apparently decreased length from the nasal root to the nasal tip. Evidence: IEA. (OMIM:615398)
- Ataxia (HP:0001251): Ataxia refers to impaired coordination of voluntary muscle movement. Cerebellar ataxia refers to ataxia due to dysfunction of the cerebellum. This causes a variety of elementary neurological deficits including asynergy (lack of coordination between muscles, limbs and joints), dysmetria (lack of ability to judge distances that can lead to under- or overshoot in grasping movements), and dysdiadochokinesia (inability to perform rapid movements requiring antagonizing muscle groups to be switched on and off repeatedly). Evidence: IEA. (OMIM:615398)
- Infantile onset (HP:0003593): Onset of signs or symptoms of disease between 28 days to one year of life. Evidence: TAS. (OMIM:615398)
- Generalized hypotonia (HP:0001290): Generalized muscular hypotonia (abnormally low muscle tone). Evidence: TAS. (OMIM:615398)
- Myoclonic seizure (HP:0032794): A myoclonic seizure is a type of motor seizure characterized by sudden, brief (<100 ms) involuntary single or multiple contraction of muscles or muscle groups of variable topography (axial, proximal limb, distal). Myoclonus is less regularly repetitive and less sustained than is clonus. Evidence: PCS. Frequency: 2/4. (PMID:23636107)
- Multifocal epileptiform discharges (HP:0010841): An abnormality in cerebral electrical activity recorded along the scalp by electroencephalography (EEG) and being identified at multiple locations (foci). Evidence: PCS. Frequency: 3/4. (PMID:23636107)
- Nystagmus (HP:0000639): Rhythmic, involuntary oscillations of one or both eyes related to abnormality in fixation, conjugate gaze, or vestibular mechanisms. Evidence: PCS. Frequency: 4/4. (PMID:23636107)
- Restrictive cardiomyopathy (HP:0001723): Restrictive left ventricular physiology is characterized by a pattern of ventricular filling in which increased stiffness of the myocardium causes ventricular pressure to rise precipitously with only small increases in volume, defined as restrictive ventricular physiology in the presence of normal or reduced diastolic volumes (of one or both ventricles), normal or reduced systolic volumes, and normal ventricular wall thickness. Evidence: TAS. (OMIM:615398)
- Patent ductus arteriosus (HP:0001643): In utero, the ductus arteriosus (DA) serves to divert ventricular output away from the lungs and toward the placenta by connecting the main pulmonary artery to the descending aorta. A patent ductus arteriosus (PDA) in the first 3 days of life is a physiologic shunt in healthy term and preterm newborn infants, and normally is substantially closed within about 24 hours after bith and completely closed after about three weeks. Failure of physiologcal closure is referred to a persistent or patent ductus arteriosus (PDA). Depending on the degree of left-to-right shunting, PDA can have clinical consequences. Evidence: TAS. (OMIM:615398)
- Intellectual disability (HP:0001249): The term intellectual disability or intellectual developmental disorder is used to describe significantly sub-average intellectual and adaptive functioning based on clinical assessment and as measured by individually administered, appropriately normed, standardized and validated tests of intellectual functioning and adaptive behavior, with onset during the developmental period from infancy through adolescence. Evidence: PCS. Frequency: 4/4. (PMID:23636107)
- Abnormality of eye movement (HP:0000496): An abnormality in voluntary or involuntary eye movements or their control. Evidence: TAS. (OMIM:615398)
- Babinski sign (HP:0003487): Upturning of the big toe (and sometimes fanning of the other toes) in response to stimulation of the sole of the foot. If the Babinski sign is present it can indicate damage to the corticospinal tract. Evidence: IEA. (OMIM:615398)
- Delayed skeletal maturation (HP:0002750): A decreased rate of skeletal maturation. Delayed skeletal maturation can be diagnosed on the basis of an estimation of the bone age from radiographs of specific bones in the human body. Evidence: PCS. Frequency: 4/4. (PMID:23636107)
- Global developmental delay (HP:0001263): A delay in the achievement of motor or mental milestones in the domains of development of a child, including motor skills, speech and language, cognitive skills, and social and emotional skills. This term should only be used to describe children younger than five years of age. Evidence: TAS. (OMIM:615398)
- Hypercalciuria (HP:0002150). Evidence: TAS. (OMIM:615398)
- Ankle clonus (HP:0011448): Clonus is an involuntary tendon reflex that causes repeated flexion and extension of the foot. Ankle clonus is tested by rapidly flexing the foot upward. Evidence: IEA. (OMIM:615398)
- Metopic synostosis (HP:0011330): Premature fusion of the metopic suture. Evidence: PCS. Frequency: 1/2. (PMID:23636107)
- Pectus excavatum (HP:0000767): A defect of the chest wall characterized by a depression of the sternum, giving the chest ("pectus") a caved-in ("excavatum") appearance. Evidence: PCS. Frequency: 1/4. (PMID:23636107)
- Autosomal recessive inheritance (HP:0000007): A mode of inheritance that is observed for traits related to a gene encoded on one of the autosomes (i.e., the human chromosomes 1-22) in which a trait manifests in individuals with two pathogenic alleles, either homozygotes (two copies of the same mutant allele) or compound heterozygotes (whereby each copy of a gene has a distinct mutant allele). Evidence: PCS. (PMID:23636107)
- Esotropia (HP:0000565): A form of strabismus with one or both eyes turned inward ('crossed') to a relatively severe degree, usually defined as 10 diopters or more. Evidence: IEA. (OMIM:615398)
- Brachycephaly (HP:0000248): An abnormality of skull shape characterized by a decreased anterior-posterior diameter. That is, a cephalic index greater than 81%. Alternatively, an apparently shortened anteroposterior dimension (length) of the head compared to width. Evidence: TAS. (OMIM:615398)
- Low-set ears (HP:0000369): Upper insertion of the ear to the scalp below an imaginary horizontal line drawn between the inner canthi of the eye and extending posteriorly to the ear. Evidence: IEA. (OMIM:615398)
- Narrow forehead (HP:0000341): Width of the forehead or distance between the frontotemporales is more than two standard deviations below the mean (objective); or apparently narrow intertemporal region (subjective). Evidence: TAS. (OMIM:615398)
- Congenital onset (HP:0003577): A phenotypic abnormality that is present at birth. Evidence: PCS. Frequency: 4/4. (PMID:23636107)
- Long philtrum (HP:0000343): Distance between nasal base and midline upper lip vermilion border more than 2 SD above the mean. Alternatively, an apparently increased distance between nasal base and midline upper lip vermilion border. Evidence: TAS. (OMIM:615398)
- Anteverted nares (HP:0000463): Anteriorly-facing nostrils viewed with the head in the Frankfurt horizontal and the eyes of the observer level with the eyes of the subject. This gives the appearance of an upturned nose (upturned nasal tip). Evidence: IEA. (OMIM:615398)
- Deep philtrum (HP:0002002): Accentuated, prominent philtral ridges giving rise to an exaggerated groove in the midline between the nasal base and upper vermillion border. Evidence: TAS. (OMIM:615398)
- Hypermetropia (HP:0000540): An abnormality of refraction characterized by the ability to see objects in the distance clearly, while objects nearby appear blurry. Evidence: PCS. Frequency: 4/4. (PMID:23636107)
- Cerebellar atrophy (HP:0001272): Cerebellar atrophy is defined as a cerebellum with initially normal structures, in a posterior fossa with normal size, which displays enlarged fissures (interfolial spaces) in comparison to the foliae secondary to loss of tissue. Cerebellar atrophy implies irreversible loss of tissue and result from an ongoing progressive disease until a final stage is reached or a single injury, e.g. an intoxication or infectious event. Evidence: PCS. Frequency: 2/4. (PMID:23636107)
- Generalized non-motor (absence) seizure (HP:0002121): A generalized non-motor (absence) seizure is a type of a type of dialeptic seizure that is of electrographically generalized onset. It is a generalized seizure characterized by an interruption of activities, a blank stare, and usually the person will be unresponsive when spoken to. Any ictal motor phenomena are minor in comparison to these non-motor features. Evidence: PCS. Frequency: 1/4. (PMID:23636107)
- Osteoporosis (HP:0000939): Osteoporosis is a systemic skeletal disease characterized by low bone density and microarchitectural deterioration of bone tissue with a consequent increase in bone fragility. According to the WHO criteria, osteoporosis is defined as a BMD that lies 2.5 standard deviations or more below the average value for young healthy adults (a T-score below -2.5 SD). Evidence: TAS. (OMIM:615398)
- Cerebral visual impairment (HP:0100704): A form of loss of vision caused by damage to the visual cortex rather than a defect in the eye. Evidence: PCS. Frequency: 4/4. (PMID:23636107)
- Osteopenia (HP:0000938): Osteopenia is a term to define bone density that is not normal but also not as low as osteoporosis. By definition from the World Health Organization osteopenia is defined by bone densitometry as a T score -1 to -2.5. Evidence: TAS. (OMIM:615398)
- Downturned corners of mouth (HP:0002714): A morphological abnormality of the mouth in which the angle of the mouth is downturned. The oral commissures are positioned inferior to the midline labial fissure. Evidence: TAS. (OMIM:615398)
- High palate (HP:0000218): Height of the palate more than 2 SD above the mean (objective) or palatal height at the level of the first permanent molar more than twice the height of the teeth (subjective). Evidence: TAS. (OMIM:615398)
- Macrocephaly (HP:0000256): Occipitofrontal (head) circumference greater than 97th centile compared to appropriate, age matched, sex-matched normal standards. Alternatively, a apparently increased size of the cranium. Evidence: TAS. (OMIM:615398)
- Cerebral atrophy (HP:0002059): Atrophy (wasting, decrease in size of cells or tissue) affecting the cerebrum. Evidence: PCS. Frequency: 2/4. (PMID:23636107)
- Large for gestational age (HP:0001520): The term large for gestational age applies to babies whose birth weight lies above the 90th percentile for that gestational age. Evidence: TAS. (OMIM:615398)
- Scoliosis (HP:0002650): The presence of an abnormal lateral curvature of the spine. Evidence: PCS. Frequency: 2/4. (PMID:23636107)
- Cerebellar hypoplasia (HP:0001321): Cerebellar hypoplasia is a descriptive term implying a cerebellum with a reduced volume, but a normal shape and is stable over time. Evidence: TAS. (OMIM:615398)
- Developmental regression (HP:0002376): Loss of developmental skills, as manifested by loss of developmental milestones. Evidence: IEA. (OMIM:615398)
- Hypoplasia of the ulna (HP:0003022): Underdevelopment of the ulna. Evidence: TAS. (OMIM:615398)
- Open mouth (HP:0000194): A facial appearance characterized by a permanently or nearly permanently opened mouth. Evidence: TAS. (OMIM:615398)
- Hydroureter (HP:0000072): The distention of the ureter with urine. Evidence: PCS. Frequency: 3/4. (PMID:23636107)
- Inverted nipples (HP:0003186): The presence of nipples that instead of pointing outward are retracted inwards. Evidence: PCS. Frequency: 2/4. (PMID:23636107)
- Ureteral stenosis (HP:0000071): The presence of a stenotic, i.e., constricted ureter. Evidence: TAS. (OMIM:615398)
- Depressed nasal bridge (HP:0005280): Posterior positioning of the nasal root in relation to the overall facial profile for age. Evidence: TAS. (OMIM:615398)
- Renal cyst (HP:0000107): A fluid filled sac in the kidney. Evidence: PCS. Frequency: 1/4. (PMID:23636107)
- High forehead (HP:0000348): An abnormally increased height of the forehead. Evidence: TAS. (OMIM:615398)
- Visual impairment (HP:0000505): Visual impairment (or vision impairment) is vision loss (of a person) to such a degree as to qualify as an additional support need through a significant limitation of visual capability resulting from either disease, trauma, or congenital or degenerative conditions that cannot be corrected by conventional means, such as refractive correction, medication, or surgery. Evidence: TAS. (OMIM:615398)